- Hypertension (HP:0000822): The presence of chronic increased pressure in the systemic arterial system. Evidence: TAS. Frequency: Frequent (HP:0040282). (ORPHA:330015)
- Vomiting (HP:0002013): Forceful ejection of the contents of the stomach through the mouth by means of a series of involuntary spasmic contractions. Evidence: TAS. Frequency: Frequent (HP:0040282). (ORPHA:330015)
- Nausea (HP:0002018): A sensation of unease in the stomach together with an urge to vomit. Evidence: TAS. Frequency: Frequent (HP:0040282). (ORPHA:330015)
- Constipation (HP:0002019): Infrequent or difficult evacuation of feces. Evidence: TAS. Frequency: Frequent (HP:0040282). (ORPHA:330015)
- Abdominal pain (HP:0002027): An unpleasant sensation characterized by physical discomfort (such as pricking, throbbing, or aching) and perceived to originate in the abdomen. Evidence: TAS. Frequency: Frequent (HP:0040282). (ORPHA:330015)
- Anorexia (HP:0002039): Lack of desire to eat (loss of appetite). Evidence: TAS. Frequency: Frequent (HP:0040282). (ORPHA:330015)
- Abdominal distention (HP:0003270): Distention of the abdomen. Evidence: TAS. Frequency: Frequent (HP:0040282). (ORPHA:330015)
- Fatigue (HP:0012378): A subjective feeling of tiredness characterized by a lack of energy and motivation. Evidence: TAS. Frequency: Frequent (HP:0040282). (ORPHA:330015)
- Renal tubular dysfunction (HP:0000124): Abnormal function of the renal tubule. The basic functional unit of the kidney, the nephron, consists of a renal corpuscle attached to a renal tubule, with roughly 0.8 to 1.5 nephrons per adult kidney. The functions of the renal tubule include reabsorption of water, electrolytes, glucose, and amino acids and secretion of substances such as uric acid. Evidence: TAS. Frequency: Occasional (HP:0040283). (ORPHA:330015)
- Delayed eruption of teeth (HP:0000684): Delayed tooth eruption, which can be defined as tooth eruption more than 2 SD beyond the mean eruption age. Evidence: TAS. Frequency: Occasional (HP:0040283). (ORPHA:330015)
- Atypical behavior (HP:0000708): Atypical behavior is an abnormality in a person's actions that can be controlled or modulated by the will of the individual. While abnormal behaviors can be difficult to control, they are distinct from other abnormal actions that cannot be affected by the individual's will. Evidence: TAS. Frequency: Occasional (HP:0040283). (ORPHA:330015)
- Depression (HP:0000716): Frequently experiencing feelings of being down, miserable, and/or hopeless; struggling to recover from these moods; having a pessimistic outlook on the future; feeling a pervasive sense of shame; having a low self-worth; experiencing thoughts of suicide and engaging in suicidal behavior. Evidence: TAS. Frequency: Occasional (HP:0040283). (ORPHA:330015)
- Skin rash (HP:0000988): A red eruption of the skin. Evidence: TAS. Frequency: Occasional (HP:0040283). (ORPHA:330015)
- Specific learning disability (HP:0001328): Impairment of certain skills such as reading or writing, coordination, self-control, or attention that interfere with the ability to learn. The impairment is not related to a global deficiency of intelligence. Evidence: TAS. Frequency: Occasional (HP:0040283). (ORPHA:330015)
- Small for gestational age (HP:0001518): Smaller than normal size according to sex and gestational age related norms, defined as a weight below the 10th percentile for the gestational age. Evidence: TAS. Frequency: Occasional (HP:0040283). (ORPHA:330015)
- Premature birth (HP:0001622): The birth of a baby of less than 37 weeks of gestational age. Evidence: TAS. Frequency: Occasional (HP:0040283). (ORPHA:330015)
- Anemia (HP:0001903): A reduction in erythrocytes volume or hemoglobin concentration. Evidence: TAS. Frequency: Occasional (HP:0040283). (ORPHA:330015)
- Headache (HP:0002315): Cephalgia, or pain sensed in various parts of the head, not confined to the area of distribution of any nerve. Evidence: TAS. Frequency: Occasional (HP:0040283). (ORPHA:330015)
- Memory impairment (HP:0002354): An impairment of memory as manifested by a reduced ability to remember things such as dates and names, and increased forgetfulness. Evidence: TAS. Frequency: Occasional (HP:0040283). (ORPHA:330015)
- Distal muscle weakness (HP:0002460): Reduced strength of the musculature of the distal extremities. Evidence: TAS. Frequency: Occasional (HP:0040283). (ORPHA:330015)
- Abnormality of the immune system (HP:0002715): An abnormality of the immune system. Evidence: TAS. Frequency: Occasional (HP:0040283). (ORPHA:330015)
- Abnormal respiratory system physiology (HP:0002795): Abnormal function of the respiratory system. Evidence: TAS. Frequency: Occasional (HP:0040283). (ORPHA:330015)
- Miscarriage (HP:0005268): A pregnancy that ends at a stage in which the fetus is incapable of surviving on its own, defined as the spontaneous loss of a fetus before the 22th week of pregnancy. Evidence: TAS. Frequency: Occasional (HP:0040283). (ORPHA:330015)
- Imbalanced hemoglobin synthesis (HP:0005560): Normal hemoglobin synthesis is characterized by production of equal amounts of alpha and beta globins. This term refers to a deviation from this pattern and is the main characteristic of the various forms of thalassemia. Evidence: TAS. Frequency: Occasional (HP:0040283). (ORPHA:330015)
- Poor fine motor coordination (HP:0007010): An abnormality of the ability (skills) to perform a precise movement of small muscles with the intent to perform a specific act. Fine motor skills are required to mediate movements of the wrists, hands, fingers, feet, and toes. Evidence: TAS. Frequency: Occasional (HP:0040283). (ORPHA:330015)
- Poor gross motor coordination (HP:0007015): An abnormality of the ability (skills) to perform a precise movement of large muscles with the intent to perform a specific act. Gross motor skills are required to mediate movements of the arms, legs, and other large body parts. Evidence: TAS. Frequency: Occasional (HP:0040283). (ORPHA:330015)
- Attention deficit hyperactivity disorder (HP:0007018): Attention deficit hyperactivity disorder (ADHD) manifests at age 2-3 years or by first grade at the latest. The main symptoms are distractibility, impulsivity, hyperactivity, and often trouble organizing tasks and projects, difficulty going to sleep, and social problems from being aggressive, loud, or impatient. Evidence: TAS. Frequency: Occasional (HP:0040283). (ORPHA:330015)
- Impairment of activities of daily living (HP:0031058): Difficulty in performing one or more activities normally performed every day, such as eating, bathing, dressing, grooming, work, homemaking, and leisure. Evidence: TAS. Frequency: Occasional (HP:0040283). (ORPHA:330015)
- Abdominal cramps (HP:0032155): A type of abdominal pain characterized by a feeling of contractions and typically fluctuating in intensity. Evidence: TAS. Frequency: Occasional (HP:0040283). (ORPHA:330015)
- Abnormal circulating vitamin D concentration (HP:0100511): Concentration of vitamin D or a vitamin D metabolite in the blood circulation outside of normal limits. Evidence: TAS. Frequency: Occasional (HP:0040283). (ORPHA:330015)
- Decreased circulating vitamin D concentration (HP:0100512): The concentration of vitamin D in the blood circulation is below the lower limit of normal. Evidence: TAS. Frequency: Occasional (HP:0040283). (ORPHA:330015)
- Cognitive impairment (HP:0100543): Abnormal cognition is characterized by deficits in thinking, reasoning, or remembering. Evidence: TAS. Frequency: Occasional (HP:0040283). (ORPHA:330015)
- Preeclampsia (HP:0100602): Pregnancy-induced hypertension in association with significant amounts of protein in the urine. Evidence: TAS. Frequency: Occasional (HP:0040283). (ORPHA:330015)
- Insomnia (HP:0100785): Persistent difficulty in starting or maintaining sleep, or waking up earlier than desired, despite having adequate opportunities and conditions for sleep. Evidence: TAS. Frequency: Occasional (HP:0040283). (ORPHA:330015)
- Abnormality of the menstrual cycle (HP:0000140): An abnormality of the ovulation cycle. Evidence: TAS. Frequency: Very rare (HP:0040284). (ORPHA:330015)
- Infertility (HP:0000789). Evidence: TAS. Frequency: Very rare (HP:0040284). (ORPHA:330015)
- Oligozoospermia (HP:0000798): Reduced count of spermatozoa in the semen, defined as a sperm count below 20 million per milliliter semen. Evidence: TAS. Frequency: Very rare (HP:0040284). (ORPHA:330015)
- Delayed puberty (HP:0000823): Passing the age when puberty normally occurs with no physical or hormonal signs of the onset of puberty. Evidence: TAS. Frequency: Very rare (HP:0040284). (ORPHA:330015)
- Intellectual disability (HP:0001249): The term intellectual disability or intellectual developmental disorder is used to describe significantly sub-average intellectual and adaptive functioning based on clinical assessment and as measured by individually administered, appropriately normed, standardized and validated tests of intellectual functioning and adaptive behavior, with onset during the developmental period from infancy through adolescence. Evidence: TAS. Frequency: Very rare (HP:0040284). (ORPHA:330015)
- Seizure (HP:0001250): A seizure is an intermittent abnormality of nervous system physiology characterized by a transient occurrence of signs and/or symptoms due to abnormal excessive or synchronous neuronal activity in the brain. Evidence: TAS. Frequency: Very rare (HP:0040284). (ORPHA:330015)
- Coma (HP:0001259): The complete absence of wakefulness and consciousness, which is evident through a lack of response to any form of external stimuli. Evidence: TAS. Frequency: Very rare (HP:0040284). (ORPHA:330015)
- Encephalopathy (HP:0001298): Encephalopathy is a term that means brain disease, damage, or malfunction. In general, encephalopathy is manifested by an altered mental state. Evidence: TAS. Frequency: Very rare (HP:0040284). (ORPHA:330015)
- Tubulointerstitial nephritis (HP:0001970): A form of inflammation of the kidney affecting the interstitium of the kidneys surrounding the tubules. Evidence: TAS. Frequency: Very rare (HP:0040284). (ORPHA:330015)
- Asthma (HP:0002099): Asthma is characterized by increased responsiveness of the tracheobronchial tree to multiple stimuli, leading to narrowing of the air passages with resultant dyspnea, cough, and wheezing. Evidence: TAS. Frequency: Very rare (HP:0040284). (ORPHA:330015)
- Abnormality of the autonomic nervous system (HP:0002270): An abnormality of the autonomic nervous system. Evidence: TAS. Frequency: Very rare (HP:0040284). (ORPHA:330015)
- Delayed skeletal maturation (HP:0002750): A decreased rate of skeletal maturation. Delayed skeletal maturation can be diagnosed on the basis of an estimation of the bone age from radiographs of specific bones in the human body. Evidence: TAS. Frequency: Very rare (HP:0040284). (ORPHA:330015)
- Abnormal T cell morphology (HP:0002843): Abnormal increase or decrease of total or subset T cell count. T cells are commonly characterized as CD3+ lymphocytes, or their subpopulations, in the blood, compared to a reference range for a given sex and age-group, measured ex vivo. These may include both TCR alpha/beta and gamma/delta T cells. Evidence: TAS. Frequency: Very rare (HP:0040284). (ORPHA:330015)
- Elevated circulating LDL-C concentration (HP:0003141): The concentration of low-density lipoprotein cholesterol in the blood circulation is above the upper limit of normal. Evidence: TAS. Frequency: Very rare (HP:0040284). (ORPHA:330015)
- Increased circulating IgE concentration (HP:0003212): An abnormally increased overall level of immunoglobulin E in blood. Evidence: TAS. Frequency: Very rare (HP:0040284). (ORPHA:330015)
- Decreased circulating HDL-C concentration (HP:0003233): The concentration of high-density lipoprotein cholesterol in the blood circulation is below the lower limit of normal. Evidence: TAS. Frequency: Very rare (HP:0040284). (ORPHA:330015)
- Somatic sensory dysfunction (HP:0003474): An abnormality of the primary sensation that is mediated by peripheral nerves (pain, temperature, touch, vibration, joint position). The word hypoesthesia (or hypesthesia) refers to a reduction in cutaneous sensation to a specific type of testing. Evidence: TAS. Frequency: Very rare (HP:0040284). (ORPHA:330015)
- Cranial hyperostosis (HP:0004437): Excessive growth of the bones of cranium, i.e., of the skull. Evidence: TAS. Frequency: Very rare (HP:0040284). (ORPHA:330015)
- Abnormality of humoral immunity (HP:0005368): An abnormality of the humoral immune system, which comprises antibodies produced by B cells as well as the complement system. Evidence: TAS. Frequency: Very rare (HP:0040284). (ORPHA:330015)
- Motor polyneuropathy (HP:0007178). Evidence: TAS. Frequency: Very rare (HP:0040284). (ORPHA:330015)
- Peripheral neuropathy (HP:0009830): Peripheral neuropathy is a general term for any disorder of the peripheral nervous system. The main clinical features used to classify peripheral neuropathy are distribution, type (mainly demyelinating versus mainly axonal), duration, and course. Evidence: TAS. Frequency: Very rare (HP:0040284). (ORPHA:330015)
- Reduced sperm motility (HP:0012207): An abnormal reduction in the mobility of ejaculated sperm. Evidence: TAS. Frequency: Very rare (HP:0040284). (ORPHA:330015)
- Chronic kidney disease (HP:0012622): Functional anomaly of the kidney persisting for at least three months. Evidence: TAS. Frequency: Very rare (HP:0040284). (ORPHA:330015)
- Reduced social responsiveness (HP:0012760): A reduced ability to participate in the back-and-forth flow of social interaction appropriate to culture and developmental level, which is normally characterized by an influence of the behavior of one person on the behavior of another person. This results in difficulty interacting with others through emotional, physical, or verbal communication. Evidence: TAS. Frequency: Very rare (HP:0040284). (ORPHA:330015)
- Abnormal sperm morphology (HP:0012864): A structural anomaly of sperm. Evidence: TAS. Frequency: Very rare (HP:0040284). (ORPHA:330015)
- Decreased female libido (HP:0030018): Diminished sexual desire in female. Evidence: TAS. Frequency: Very rare (HP:0040284). (ORPHA:330015)
- Decreased circulating osteocalcin level (HP:0031429): A reduced level of osteocalcin in the blood. Evidence: TAS. Frequency: Very rare (HP:0040284). (ORPHA:330015)
- Decreased male libido (HP:0040306): Reduced desire for sexual activity on the part of a male. Evidence: TAS. Frequency: Very rare (HP:0040284). (ORPHA:330015)
These phenotypes are associated with the disease Lead poisoning (ORPHA:330015).